- Intrauterine growth retardation (HP:0001511): An abnormal restriction of fetal growth with fetal weight below the tenth percentile for gestational age. Evidence: TAS. Frequency: Occasional (HP:0040283). (ORPHA:2308)
- Death in infancy (HP:0001522): Death within the first 24 months of life. Evidence: TAS. Frequency: Occasional (HP:0040283). (ORPHA:2308)
- Aortic valve stenosis (HP:0001650): The presence of a stenosis (narrowing) of the aortic valve. Evidence: TAS. Frequency: Occasional (HP:0040283). (ORPHA:2308)
- Coarctation of aorta (HP:0001680): Coarctation of the aorta is a narrowing or constriction of a segment of the aorta. Evidence: TAS. Frequency: Occasional (HP:0040283). (ORPHA:2308)
- Intellectual disability (HP:0001249): The term intellectual disability or intellectual developmental disorder is used to describe significantly sub-average intellectual and adaptive functioning based on clinical assessment and as measured by individually administered, appropriately normed, standardized and validated tests of intellectual functioning and adaptive behavior, with onset during the developmental period from infancy through adolescence. Evidence: TAS. Frequency: Very frequent (HP:0040281). (ORPHA:2308)
- Global developmental delay (HP:0001263): A delay in the achievement of motor or mental milestones in the domains of development of a child, including motor skills, speech and language, cognitive skills, and social and emotional skills. This term should only be used to describe children younger than five years of age. Evidence: TAS. Frequency: Very frequent (HP:0040281). (ORPHA:2308)
- Growth delay (HP:0001510): A deficiency or slowing down of growth pre- and postnatally. Evidence: TAS. Frequency: Very frequent (HP:0040281). (ORPHA:2308)
- Thrombocytopenia (HP:0001873): A reduction in the number of circulating thrombocytes. Evidence: TAS. Frequency: Very frequent (HP:0040281). (ORPHA:2308)
- Bone marrow hypocellularity (HP:0005528): A reduced number of hematopoietic cells present in the bone marrow relative to marrow fat. Evidence: TAS. Frequency: Very frequent (HP:0040281). (ORPHA:2308)
- Feeding difficulties in infancy (HP:0008872): Impaired feeding performance of an infant as manifested by difficulties such as weak and ineffective sucking, brief bursts of sucking, and falling asleep during sucking. There may be difficulties with chewing or maintaining attention. Evidence: TAS. Frequency: Very frequent (HP:0040281). (ORPHA:2308)
- Cryptorchidism (HP:0000028): Testis in inguinal canal. That is, absence of one or both testes from the scrotum owing to failure of the testis or testes to descend through the inguinal canal to the scrotum. Evidence: TAS. Frequency: Frequent (HP:0040282). (ORPHA:2308)
- Macrocephaly (HP:0000256): Occipitofrontal (head) circumference greater than 97th centile compared to appropriate, age matched, sex-matched normal standards. Alternatively, a apparently increased size of the cranium. Evidence: TAS. Frequency: Frequent (HP:0040282). (ORPHA:2308)
- Epicanthus (HP:0000286): A fold of skin starting above the medial aspect of the upper eyelid and arching downward to cover, pass in front of and lateral to the medial canthus. Evidence: TAS. Frequency: Frequent (HP:0040282). (ORPHA:2308)
- Hypertelorism (HP:0000316): Interpupillary distance more than 2 SD above the mean (alternatively, the appearance of an increased interpupillary distance or widely spaced eyes). Evidence: TAS. Frequency: Frequent (HP:0040282). (ORPHA:2308)
- Smooth philtrum (HP:0000319): Flat skin surface, with no ridge formation in the central region of the upper lip between the nasal base and upper vermilion border. Evidence: TAS. Frequency: Frequent (HP:0040282). (ORPHA:2308)
- Facial asymmetry (HP:0000324): An abnormal difference between the left and right sides of the face. Evidence: TAS. Frequency: Frequent (HP:0040282). (ORPHA:2308)
- Long philtrum (HP:0000343): Distance between nasal base and midline upper lip vermilion border more than 2 SD above the mean. Alternatively, an apparently increased distance between nasal base and midline upper lip vermilion border. Evidence: TAS. Frequency: Frequent (HP:0040282). (ORPHA:2308)
- High forehead (HP:0000348): An abnormally increased height of the forehead. Evidence: TAS. Frequency: Frequent (HP:0040282). (ORPHA:2308)
- Anteverted nares (HP:0000463): Anteriorly-facing nostrils viewed with the head in the Frankfurt horizontal and the eyes of the observer level with the eyes of the subject. This gives the appearance of an upturned nose (upturned nasal tip). Evidence: TAS. Frequency: Frequent (HP:0040282). (ORPHA:2308)
- Short neck (HP:0000470): Diminished length of the neck. Evidence: TAS. Frequency: Frequent (HP:0040282). (ORPHA:2308)
- Microcornea (HP:0000482): A congenital abnormality of the cornea in which the cornea and the anterior segment of the eye are smaller than normal. The horizontal diameter of the cornea does not reach 10 mm even in adulthood. Evidence: TAS. Frequency: Frequent (HP:0040282). (ORPHA:2308)
- Strabismus (HP:0000486): A misalignment of the eyes so that the visual axes deviate from bifoveal fixation. The classification of strabismus may be based on a number of features including the relative position of the eyes, whether the deviation is latent or manifest, intermittent or constant, concomitant or otherwise and according to the age of onset and the relevance of any associated refractive error. Evidence: TAS. Frequency: Frequent (HP:0040282). (ORPHA:2308)
- Downslanted palpebral fissures (HP:0000494): The palpebral fissure inclination is more than two standard deviations below the mean. Evidence: TAS. Frequency: Frequent (HP:0040282). (ORPHA:2308)
- Ptosis (HP:0000508): The upper eyelid margin is positioned 3 mm or more lower than usual and covers the superior portion of the iris (objective); or, the upper lid margin obscures at least part of the pupil (subjective). Evidence: TAS. Frequency: Frequent (HP:0040282). (ORPHA:2308)
- Missing ribs (HP:0000921): A developmental anomaly with absence of one or more ribs. Evidence: TAS. Frequency: Frequent (HP:0040282). (ORPHA:2308)
- Premature birth (HP:0001622): The birth of a baby of less than 37 weeks of gestational age. Evidence: TAS. Frequency: Frequent (HP:0040282). (ORPHA:2308)
- Ventricular septal defect (HP:0001629): A hole between the two bottom chambers (ventricles) of the heart. The defect is centered around the most superior aspect of the ventricular septum. Evidence: TAS. Frequency: Frequent (HP:0040282). (ORPHA:2308)
- Pes planus (HP:0001763): A foot where the longitudinal arch of the foot is in contact with the ground or floor when the individual is standing; or, in a patient lying supine, a foot where the arch is in contact with the surface of a flat board pressed against the sole of the foot by the examiner with a pressure similar to that expected from weight bearing; or, the height of the arch is reduced. Evidence: TAS. Frequency: Frequent (HP:0040282). (ORPHA:2308)
- Toe syndactyly (HP:0001770): Webbing or fusion of the toes, involving soft parts only or including bone structure. Bony fusions are referred to as "bony" Syndactyly if the fusion occurs in a radio-ulnar axis. Fusions of bones of the toes in a proximo-distal axis are referred to as "Symphalangism". Evidence: TAS. Frequency: Frequent (HP:0040282). (ORPHA:2308)
- Short toe (HP:0001831): A toe that appears disproportionately short compared to the foot. Evidence: TAS. Frequency: Frequent (HP:0040282). (ORPHA:2308)
- Long hallux (HP:0001847): Increased length of the big toe. Evidence: TAS. Frequency: Frequent (HP:0040282). (ORPHA:2308)
- Toe clinodactyly (HP:0001863): Bending or curvature of a toe in the tibial direction (i.e., towards the big toe). Evidence: TAS. Frequency: Frequent (HP:0040282). (ORPHA:2308)
- Frontal bossing (HP:0002007): Bilateral bulging of the lateral frontal bone prominences with relative sparing of the midline. Evidence: TAS. Frequency: Frequent (HP:0040282). (ORPHA:2308)
- Constipation (HP:0002019): Infrequent or difficult evacuation of feces. Evidence: TAS. Frequency: Frequent (HP:0040282). (ORPHA:2308)
- Ventriculomegaly (HP:0002119): An increase in size of the ventricular system of the brain. Evidence: TAS. Frequency: Frequent (HP:0040282). (ORPHA:2308)
- Recurrent respiratory infections (HP:0002205): An increased susceptibility to respiratory infections as manifested by a history of recurrent respiratory infections. Evidence: TAS. Frequency: Frequent (HP:0040282). (ORPHA:2308)
- Short nose (HP:0003196): Distance from nasion to subnasale more than two standard deviations below the mean, or alternatively, an apparently decreased length from the nasal root to the nasal tip. Evidence: TAS. Frequency: Frequent (HP:0040282). (ORPHA:2308)
- Abnormal vertebral body morphology (HP:0003312): Abnormal form of vertebral body, which is the central cylindrical portion of the vertebra that together with other structures such as the vertebral arch, pedicles, laminae, spinous process, transverse processes, and articular facets makes up a vertebra. Evidence: TAS. Frequency: Frequent (HP:0040282). (ORPHA:2308)
- Short stature (HP:0004322): A height below that which is expected according to age and gender norms. Although there is no universally accepted definition of short stature, many refer to "short stature" as height more than 2 standard deviations below the mean for age and gender (or below the 3rd percentile for age and gender dependent norms). Evidence: TAS. Frequency: Frequent (HP:0040282). (ORPHA:2308)
- Finger syndactyly (HP:0006101): Webbing or fusion of the fingers, involving soft parts only or including bone structure. Bony fusions are referred to as "bony" Syndactyly if the fusion occurs in a radio-ulnar axis. Fusions of bones of the fingers in a proximo-distal axis are referred to as "Symphalangism". Evidence: TAS. Frequency: Frequent (HP:0040282). (ORPHA:2308)
- Attention deficit hyperactivity disorder (HP:0007018): Attention deficit hyperactivity disorder (ADHD) manifests at age 2-3 years or by first grade at the latest. The main symptoms are distractibility, impulsivity, hyperactivity, and often trouble organizing tasks and projects, difficulty going to sleep, and social problems from being aggressive, loud, or impatient. Evidence: TAS. Frequency: Frequent (HP:0040282). (ORPHA:2308)
- Aplasia/Hypoplasia of the earlobes (HP:0009906): Absence or underdevelopment of the ear lobes. Evidence: TAS. Frequency: Frequent (HP:0040282). (ORPHA:2308)
- Broad hallux phalanx (HP:0010059): An increase in width in one or more phalanges of the big toe. Evidence: TAS. Frequency: Frequent (HP:0040282). (ORPHA:2308)
- Broad columella (HP:0010761): Increased width of the columella. Evidence: TAS. Frequency: Frequent (HP:0040282). (ORPHA:2308)
- Aplasia/Hypoplasia of the eyebrow (HP:0100840): Absence or underdevelopment of the eyebrow. Evidence: TAS. Frequency: Frequent (HP:0040282). (ORPHA:2308)
- Multicystic kidney dysplasia (HP:0000003): Multicystic dysplasia of the kidney is characterized by multiple cysts of varying size in the kidney and the absence of a normal pelvicaliceal system. The condition is associated with ureteral or ureteropelvic atresia, and the affected kidney is nonfunctional. Evidence: TAS. Frequency: Occasional (HP:0040283). (ORPHA:2308)
- Inguinal hernia (HP:0000023): Protrusion of the contents of the abdominal cavity through the inguinal canal. Evidence: TAS. Frequency: Occasional (HP:0040283). (ORPHA:2308)
- Hydronephrosis (HP:0000126): Severe distention of the kidney with dilation of the renal pelvis and calices. Evidence: TAS. Frequency: Occasional (HP:0040283). (ORPHA:2308)
- Abnormal palate morphology (HP:0000174): Any abnormality of the palate, i.e., of roof of the mouth. Evidence: TAS. Frequency: Occasional (HP:0040283). (ORPHA:2308)
- Trigonocephaly (HP:0000243): Wedge-shaped, or triangular head, with the apex of the triangle at the midline of the forehead and the base of the triangle at the occiput. Evidence: TAS. Frequency: Occasional (HP:0040283). (ORPHA:2308)
- Wide nasal bridge (HP:0000431): Increased breadth of the nasal bridge (and with it, the nasal root). Evidence: TAS. Frequency: Occasional (HP:0040283). (ORPHA:2308)
- Webbed neck (HP:0000465): Pterygium colli is a congenital skin fold that runs along the sides of the neck down to the shoulders. It involves an ectopic fibrotic facial band superficial to the trapezius muscle. Excess hair-bearing skin is also present and extends down the cervical region well beyond the normal hairline. Evidence: TAS. Frequency: Occasional (HP:0040283). (ORPHA:2308)
- Cataract (HP:0000518): A cataract is an opacity or clouding that develops in the crystalline lens of the eye or in its capsule. Evidence: TAS. Frequency: Occasional (HP:0040283). (ORPHA:2308)
- Iris coloboma (HP:0000612): A coloboma of the iris. Evidence: TAS. Frequency: Occasional (HP:0040283). (ORPHA:2308)
- Eyelid coloboma (HP:0000625): A short discontinuity of the margin of the lower or upper eyelid. Evidence: TAS. Frequency: Occasional (HP:0040283). (ORPHA:2308)
- Ectropion (HP:0000656): An outward turning (eversion) or rotation of the eyelid margin. Evidence: TAS. Frequency: Occasional (HP:0040283). (ORPHA:2308)
- Eczematoid dermatitis (HP:0000964): Eczema is a form of dermatitis that is characterized by scaly, pruritic, erythematous lesions located on flexural surfaces. Evidence: TAS. Frequency: Occasional (HP:0040283). (ORPHA:2308)
- Hand polydactyly (HP:0001161): A kind of polydactyly characterized by the presence of a supernumerary finger or fingers. Evidence: TAS. Frequency: Occasional (HP:0040283). (ORPHA:2308)
- Seizure (HP:0001250): A seizure is an intermittent abnormality of nervous system physiology characterized by a transient occurrence of signs and/or symptoms due to abnormal excessive or synchronous neuronal activity in the brain. Evidence: TAS. Frequency: Occasional (HP:0040283). (ORPHA:2308)
- Agenesis of corpus callosum (HP:0001274): Absence of the corpus callosum as a result of the failure of the corpus callosum to develop, which can be the result of a failure in any one of the multiple steps of callosal development including cellular proliferation and migration, axonal growth or glial patterning at the midline. Evidence: TAS. Frequency: Occasional (HP:0040283). (ORPHA:2308)
- Pachygyria (HP:0001302): Pachygyria is a malformation of cortical development with abnormally wide gyri with sulci 1,5-3 cm apart and abnormally thick cortex measuring more than 5 mm (radiological definition). See also neuropathological definitions for 2-, 3-, and 4-layered lissencephaly. Evidence: TAS. Frequency: Occasional (HP:0040283). (ORPHA:2308)
- Annular pancreas (HP:0001734): A congenital anomaly in which the pancreas completely (or sometimes incompletely) encircles the second portion of duodenum and occasionally obstructs the more proximal duodenum. Evidence: TAS. Frequency: Occasional (HP:0040283). (ORPHA:2308)
- Talipes (HP:0001883): A deformity of foot and ankle that has different subtypes that are talipes equinovarus, talipes equinovalgus, talipes calcaneovarus and talipes calcaneovalgus. Evidence: TAS. Frequency: Occasional (HP:0040283). (ORPHA:2308)
- Pyloric stenosis (HP:0002021): Pyloric stenosis, also known as infantile hypertrophic pyloric stenosis, is an uncommon condition in infants characterized by abnormal thickening of the pylorus muscles in the stomach leading to gastric outlet obstruction. Clinically infants are well at birth. Then, at 3 to 6 weeks of age, the infants present with projectile vomiting, potentially leading to dehydration and weight loss. Evidence: TAS. Frequency: Occasional (HP:0040283). (ORPHA:2308)
- Cerebral atrophy (HP:0002059): Atrophy (wasting, decrease in size of cells or tissue) affecting the cerebrum. Evidence: TAS. Frequency: Occasional (HP:0040283). (ORPHA:2308)
- Duodenal atresia (HP:0002247): A developmental defect resulting in complete obliteration of the duodenal lumen, that is, an abnormal closure of the duodenum. Evidence: TAS. Frequency: Occasional (HP:0040283). (ORPHA:2308)
- Spina bifida (HP:0002414): Incomplete closure of the embryonic neural tube, whereby some vertebral arches remain unfused and open. The mildest form is spina bifida occulta, followed by meningocele and meningomyelocele. Evidence: TAS. Frequency: Occasional (HP:0040283). (ORPHA:2308)
- Intestinal malrotation (HP:0002566): An abnormality of the intestinal rotation and fixation that normally occurs during the development of the gut. This can lead to volvulus, or twisting of the intestine that causes obstruction and necrosis. Evidence: TAS. Frequency: Occasional (HP:0040283). (ORPHA:2308)
- Scoliosis (HP:0002650): The presence of an abnormal lateral curvature of the spine. Evidence: TAS. Frequency: Occasional (HP:0040283). (ORPHA:2308)
- Hip dislocation (HP:0002827): Displacement of the femur from its normal location in the hip joint. Evidence: TAS. Frequency: Occasional (HP:0040283). (ORPHA:2308)
- Abnormality of the anus (HP:0004378): Abnormality of the anal canal. Evidence: TAS. Frequency: Occasional (HP:0040283). (ORPHA:2308)
- Hypoplastic left ventricle (HP:0004383): A severe congenital heart defect characterized by underdevelopment of the left ventricle. Evidence: TAS. Frequency: Occasional (HP:0040283). (ORPHA:2308)
- Ectopic anus (HP:0004397): Abnormal displacement or malposition of the anus. Evidence: TAS. Frequency: Occasional (HP:0040283). (ORPHA:2308)
- Bipolar affective disorder (HP:0007302): Bipolar disorder is an illness of mood characterized by alternating episodes of elevated and depressed moods, which are interspersed with euthymic periods. Evidence: TAS. Frequency: Occasional (HP:0040283). (ORPHA:2308)
- Schizophrenia (HP:0100753): A mental disorder characterized by a disintegration of thought processes and emotional responsiveness. It most commonly manifests as auditory hallucinations, paranoid or bizarre delusions, or disorganized speech and thinking. It is accompanied by significant social or occupational dysfunction. The onset of symptoms typically occurs in young adulthood, with a global lifetime prevalence of about 1%. This term is not a helpful parent term to describe abnormal experiences. Evidence: TAS. Frequency: Occasional (HP:0040283). (ORPHA:2308)
- Posteriorly rotated ears (HP:0000358): A type of abnormal location of the ears in which the position of the ears is characterized by posterior rotation (the superior part of the ears is rotated towards the back of the head, and the inferior part of the ears towards the front). Evidence: TAS. Frequency: Frequent (HP:0040282). (ORPHA:2308)
These phenotypes are associated with the disease Jacobsen syndrome (ORPHA:2308).